Phenotypes associated with the disease neurodevelopmental disorder with poor growth, large ears, and dysmorphic facies (OMIM:620194):
- Preauricular skin tag (HP:0000384): A rudimentary tag of skin often containing ear tissue including a core of cartilage and located just anterior to the auricle (outer part of the ear). Evidence: PCS. Frequency: 2/3. (PMID:34313816)
- Recurrent lower respiratory tract infections (HP:0002783): An increased susceptibility to lower respiratory tract infections as manifested by a history of recurrent lower respiratory tract infections. Evidence: PCS. Frequency: 1/3. (PMID:34313816)
- Seizure (HP:0001250): A seizure is an intermittent abnormality of nervous system physiology characterized by a transient occurrence of signs and/or symptoms due to abnormal excessive or synchronous neuronal activity in the brain. Evidence: PCS. Frequency: 2/3. (PMID:34313816)
- Hypotonia (HP:0001252): Hypotonia is an abnormally low muscle tone (the amount of tension or resistance to movement in a muscle). Even when relaxed, muscles have a continuous and passive partial contraction which provides some resistance to passive stretching. Hypotonia thus manifests as diminished resistance to passive stretching. Hypotonia is not the same as muscle weakness, although the two conditions can co-exist. Evidence: PCS. Frequency: 3/3. (PMID:34313816)
- Infantile onset (HP:0003593): Onset of signs or symptoms of disease between 28 days to one year of life. Evidence: PCS. Frequency: 3/3. (PMID:34313816)
- Lower limb spasticity (HP:0002061): Spasticity (velocity-dependent increase in tonic stretch reflexes with increased muscle tone and hyperexcitable tendon reflexes) in the muscles of the lower limbs, hips, and pelvis. Evidence: PCS. Frequency: 1/3. (PMID:34313816)
- Brain atrophy (HP:0012444): Partial or complete wasting (loss) of brain tissue that was once present. Evidence: PCS. Frequency: 1/3. (PMID:34313816)
- Diabetes mellitus (HP:0000819): A group of abnormalities characterized by hyperglycemia and glucose intolerance. Evidence: PCS. Frequency: 1/3. (PMID:34313816)
- Failure to thrive (HP:0001508): Failure to thrive (FTT) refers to a child whose physical growth is substantially below the norm. Evidence: PCS. Frequency: 3/3. (PMID:34313816)
- Osteopenia (HP:0000938): Osteopenia is a term to define bone density that is not normal but also not as low as osteoporosis. By definition from the World Health Organization osteopenia is defined by bone densitometry as a T score -1 to -2.5. Evidence: PCS. Frequency: 1/2. (PMID:34313816)
- Hallux valgus (HP:0001822): Lateral deviation of the great toe (i.e., in the direction of the little toe). Evidence: PCS. Frequency: 2/3. (PMID:34313816)
- Long hallux (HP:0001847): Increased length of the big toe. Evidence: PCS. Frequency: 3/3. (PMID:34313816)
- Clinodactyly (HP:0030084): An angulation of a digit at an interphalangeal joint in the plane of the palm (finger) or sole (toe). Evidence: PCS. Frequency: 1/3. (PMID:34313816)
- High palate (HP:0000218): Height of the palate more than 2 SD above the mean (objective) or palatal height at the level of the first permanent molar more than twice the height of the teeth (subjective). Evidence: PCS. Frequency: 2/3. (PMID:34313816)
- Intellectual disability (HP:0001249): The term intellectual disability or intellectual developmental disorder is used to describe significantly sub-average intellectual and adaptive functioning based on clinical assessment and as measured by individually administered, appropriately normed, standardized and validated tests of intellectual functioning and adaptive behavior, with onset during the developmental period from infancy through adolescence. Evidence: PCS. Frequency: 2/2. (PMID:34313816)
- Microcephaly (HP:0000252): Head circumference below 2 standard deviations below the mean for age and gender. Evidence: PCS. Frequency: 3/3. (PMID:34313816)
- Secundum atrial septal defect (HP:0001684): A kind of atrial septum defect arising from an enlarged foramen ovale, inadequate growth of the septum secundum, or excessive absorption of the septum primum. Evidence: PCS. Frequency: 1/3. (PMID:34313816)
- Feeding difficulties (HP:0011968): Impaired ability to eat related to problems gathering food and getting ready to suck, chew, or swallow it. Evidence: PCS. Frequency: 1/3. (PMID:34313816)
- Deeply set eye (HP:0000490): An eye that is more deeply recessed into the plane of the face than is typical. Evidence: PCS. Frequency: 2/3. (PMID:34313816)
- Global developmental delay (HP:0001263): A delay in the achievement of motor or mental milestones in the domains of development of a child, including motor skills, speech and language, cognitive skills, and social and emotional skills. This term should only be used to describe children younger than five years of age. Evidence: PCS. Frequency: 3/3. (PMID:34313816)
- Broad thumb (HP:0011304): Increased thumb width without increased dorso-ventral dimension. Evidence: PCS. Frequency: 1/3. (PMID:34313816)
- Small for gestational age (HP:0001518): Smaller than normal size according to sex and gestational age related norms, defined as a weight below the 10th percentile for the gestational age. Evidence: PCS. Frequency: 3/3. (PMID:34313816)
- Prominent nose (HP:0000448): Distance between subnasale and pronasale more than two standard deviations above the mean, or alternatively, an apparently increased anterior protrusion of the nasal tip. Evidence: PCS. Frequency: 3/3. (PMID:34313816)
- Autosomal recessive inheritance (HP:0000007): A mode of inheritance that is observed for traits related to a gene encoded on one of the autosomes (i.e., the human chromosomes 1-22) in which a trait manifests in individuals with two pathogenic alleles, either homozygotes (two copies of the same mutant allele) or compound heterozygotes (whereby each copy of a gene has a distinct mutant allele). Evidence: PCS. (PMID:26633546)
- Hyperplasia of the maxilla (HP:0430028): Abnormally increased dimension of the maxilla, especially relative to the mandible, resulting in a malocclusion or malalignment between the upper and lower teeth or in anterior positioning of the nasal base, increased convexity of the face, increased nasolabial angle, or increased width (transverse dimension of the maxilla. Evidence: PCS. Frequency: 2/3. (PMID:34313816)
- Epileptic encephalopathy (HP:0200134): A condition in which epileptiform abnormalities are believed to contribute to the progressive disturbance in cerebral function. Epileptic encephalaopathy is characterized by (1) electrographic EEG paroxysmal activity that is often aggressive, (2) seizures that are usually multiform and intractable, (3) cognitive, behavioral and neurological deficits that may be relentless, and (4) sometimes early death. Evidence: PCS. Frequency: 1/3. (PMID:34313816)
- Pectus carinatum (HP:0000768): A deformity of the chest caused by overgrowth of the ribs and characterized by protrusion of the sternum. Evidence: PCS. Frequency: 1/3. (PMID:34313816)
- Macrotia (HP:0000400): Median longitudinal ear length greater than two standard deviations above the mean and median ear width greater than two standard deviations above the mean (objective); or, apparent increase in length and width of the pinna (subjective). Evidence: PCS. Frequency: 3/3. (PMID:34313816)
- Chorioretinal coloboma (HP:0000567): Absence of a region of the retina, retinal pigment epithelium, and choroid. Evidence: PCS. Frequency: 1/3. (PMID:34313816)
- Micrognathia (HP:0000347): Developmental hypoplasia of the mandible. Evidence: PCS. Frequency: 1/3. (PMID:34313816)